- Cryptorchidism (HP:0000028): Testis in inguinal canal. That is, absence of one or both testes from the scrotum owing to failure of the testis or testes to descend through the inguinal canal to the scrotum. Evidence: TAS. Frequency: Very frequent (HP:0040281). (ORPHA:289548)
- Ambiguous genitalia, male (HP:0000033): Ambiguous genitalia in an individual with XY genetic gender. Evidence: TAS. Frequency: Very frequent (HP:0040281). (ORPHA:289548)
- Male pseudohermaphroditism (HP:0000037): Hermaphroditism refers to a discrepancy between the morphology of the gonads and that of the external genitalia. In male pseudohermaphroditism, the genotype is male (XY) and the external genitalia are imcompletely virilized, ambiguous, or complete female. If gonads are present, they are testes. Evidence: TAS. Frequency: Very frequent (HP:0040281). (ORPHA:289548)
- Renal salt wasting (HP:0000127): A high concentration of one or more electrolytes in the urine in the presence of low serum concentrations of the electrolyte(s). Evidence: TAS. Frequency: Very frequent (HP:0040281). (ORPHA:289548)
- Decreased fertility (HP:0000144). Evidence: TAS. Frequency: Very frequent (HP:0040281). (ORPHA:289548)
- Aplasia of the uterus (HP:0000151): A congenital defect characterized by absence of the uterus. Aplasia refers to the failure of an organ to develop during embryonic growth and development due to the absence of primordial tissue. Evidence: TAS. Frequency: Very frequent (HP:0040281). (ORPHA:289548)
- Gynecomastia (HP:0000771): Abnormal development of large mammary glands in males resulting in breast enlargement. Evidence: TAS. Frequency: Very frequent (HP:0040281). (ORPHA:289548)
- Delayed puberty (HP:0000823): Passing the age when puberty normally occurs with no physical or hormonal signs of the onset of puberty. Evidence: TAS. Frequency: Very frequent (HP:0040281). (ORPHA:289548)
- Increased circulating renin concentration (HP:0000848): An increased level of renin in the blood. Evidence: TAS. Frequency: Very frequent (HP:0040281). (ORPHA:289548)
- Osteoporosis (HP:0000939): Osteoporosis is a systemic skeletal disease characterized by low bone density and microarchitectural deterioration of bone tissue with a consequent increase in bone fragility. According to the WHO criteria, osteoporosis is defined as a BMD that lies 2.5 standard deviations or more below the average value for young healthy adults (a T-score below -2.5 SD). Evidence: TAS. Frequency: Very frequent (HP:0040281). (ORPHA:289548)
- Abnormality of prenatal development or birth (HP:0001197): An abnormality of the fetus or the birth of the fetus, excluding structural abnormalities. Evidence: TAS. Frequency: Very frequent (HP:0040281). (ORPHA:289548)
- Agenesis of corpus callosum (HP:0001274): Absence of the corpus callosum as a result of the failure of the corpus callosum to develop, which can be the result of a failure in any one of the multiple steps of callosal development including cellular proliferation and migration, axonal growth or glial patterning at the midline. Evidence: TAS. Frequency: Very frequent (HP:0040281). (ORPHA:289548)
- Failure to thrive (HP:0001508): Failure to thrive (FTT) refers to a child whose physical growth is substantially below the norm. Evidence: TAS. Frequency: Very frequent (HP:0040281). (ORPHA:289548)
- Acidosis (HP:0001941): Abnormal acid accumulation or depletion of base. Evidence: TAS. Frequency: Very frequent (HP:0040281). (ORPHA:289548)
- Dehydration (HP:0001944). Evidence: TAS. Frequency: Very frequent (HP:0040281). (ORPHA:289548)
- Neonatal hypoglycemia (HP:0001998). Evidence: TAS. Frequency: Very frequent (HP:0040281). (ORPHA:289548)
- Vomiting (HP:0002013): Forceful ejection of the contents of the stomach through the mouth by means of a series of involuntary spasmic contractions. Evidence: TAS. Frequency: Very frequent (HP:0040281). (ORPHA:289548)
- Hyperkalemia (HP:0002153): The concentration of potassium(1+) in the blood circulation is above the upper limit of normal. Evidence: TAS. Frequency: Very frequent (HP:0040281). (ORPHA:289548)
- Hypotension (HP:0002615): Low Blood Pressure, vascular hypotension. Evidence: TAS. Frequency: Very frequent (HP:0040281). (ORPHA:289548)
- Delayed skeletal maturation (HP:0002750): A decreased rate of skeletal maturation. Delayed skeletal maturation can be diagnosed on the basis of an estimation of the bone age from radiographs of specific bones in the human body. Evidence: TAS. Frequency: Very frequent (HP:0040281). (ORPHA:289548)
- Hyponatremia (HP:0002902): The concentration of sodium in the blood circulation is below the lower limit of normal. Evidence: TAS. Frequency: Very frequent (HP:0040281). (ORPHA:289548)
- Abnormal circulating cholesterol concentration (HP:0003107): Any deviation from the normal concentration of cholesterol in the blood circulation. Evidence: TAS. Frequency: Very frequent (HP:0040281). (ORPHA:289548)
- Increased circulating ACTH level (HP:0003154): An abnormal increased in the concentration of corticotropin, also known as adrenocorticotropic hormone (ACTH), in the blood. Evidence: TAS. Frequency: Very frequent (HP:0040281). (ORPHA:289548)
- Decreased circulating aldosterone concentration (HP:0004319): Abnormally reduced levels of aldosterone. Evidence: TAS. Frequency: Very frequent (HP:0040281). (ORPHA:289548)
- Reduced bone mineral density (HP:0004349): A reduction of bone mineral density, that is, of the amount of matter per cubic centimeter of bones. Evidence: TAS. Frequency: Very frequent (HP:0040281). (ORPHA:289548)
- Generalized hyperpigmentation (HP:0007440). Evidence: TAS. Frequency: Very frequent (HP:0040281). (ORPHA:289548)
- Generalized bronze hyperpigmentation (HP:0007574). Evidence: TAS. Frequency: Very frequent (HP:0040281). (ORPHA:289548)
- Low maternal circulating estriol concentration (HP:0008073): An abnormally low concentration of serum conjugated estriol as compared to normal values for gestational-age. Evidence: TAS. Frequency: Very frequent (HP:0040281). (ORPHA:289548)
- Decreased circulating cortisol level (HP:0008163): Abnormally reduced concentration of cortisol in the blood. Evidence: TAS. Frequency: Very frequent (HP:0040281). (ORPHA:289548)
- Absence of secondary sex characteristics (HP:0008187): No secondary sexual characteristics are present at puberty. Evidence: TAS. Frequency: Very frequent (HP:0040281). (ORPHA:289548)
- Primary adrenal insufficiency (HP:0008207): Insufficient production of steroid hormones (primarily cortisol) by the adrenal glands as a result of a primary defect in the glands themselves. Evidence: TAS. Frequency: Very frequent (HP:0040281). (ORPHA:289548)
- Female external genitalia in individual with 46,XY karyotype (HP:0008730): The presence of female external genitalia in a person with a male karyotype. Evidence: TAS. Frequency: Very frequent (HP:0040281). (ORPHA:289548)
- Decreased testicular size (HP:0008734): Reduced volume of the testicle (the male gonad). Evidence: TAS. Frequency: Very frequent (HP:0040281). (ORPHA:289548)
- Abnormality of the Leydig cells (HP:0010789). Evidence: TAS. Frequency: Very frequent (HP:0040281). (ORPHA:289548)
- Hypovolemia (HP:0011106): An decrease in the amount of intravascular fluid, particularly in the volume of the circulating blood. Evidence: TAS. Frequency: Very frequent (HP:0040281). (ORPHA:289548)
- Adrenocorticotropic hormone excess (HP:0011749): Overproduction of adrenocorticotropic hormone (ACTH), which generally leads secondarily to overproduction of cortisol by the adrenal cortex. Evidence: TAS. Frequency: Very frequent (HP:0040281). (ORPHA:289548)
- Feeding difficulties (HP:0011968): Impaired ability to eat related to problems gathering food and getting ready to suck, chew, or swallow it. Evidence: TAS. Frequency: Very frequent (HP:0040281). (ORPHA:289548)
- Abnormal sex determination (HP:0012244): Anomaly of primary or secondary sexual development or characteristics. Evidence: TAS. Frequency: Very frequent (HP:0040281). (ORPHA:289548)
- Sex reversal (HP:0012245): Development of the reproductive system is inconsistent with the chromosomal sex. Evidence: TAS. Frequency: Very frequent (HP:0040281). (ORPHA:289548)
- Abnormal urine potassium concentration (HP:0012598): An abnormal concentration of potassium(1+) in the urine. Evidence: TAS. Frequency: Very frequent (HP:0040281). (ORPHA:289548)
- Hypernatriuria (HP:0012605): An increased concentration of sodium(1+) in the urine. Evidence: TAS. Frequency: Very frequent (HP:0040281). (ORPHA:289548)
- Decreased circulating androgen concentration (HP:0030349): A reduction in the blood concentration of an androgen, that is, of a steroid hormone that controls development and maintenance of masculine characteristics. The androgens include testosterone and Dehydroepiandrosterone. Evidence: TAS. Frequency: Very frequent (HP:0040281). (ORPHA:289548)
- Induced vaginal delivery (HP:0030369): Vaginal delivery following induction of labor, a procedure used to stimulate uterine contractions during pregnancy before labor begins on its own. Evidence: TAS. Frequency: Very frequent (HP:0040281). (ORPHA:289548)
- Urogenital sinus anomaly (HP:0100779): A rare birth defect in women where the urethra and vagina both open into a common channel. Evidence: TAS. Frequency: Very frequent (HP:0040281). (ORPHA:289548)
- Adrenal hypoplasia (HP:0000835): Developmental hypoplasia of the adrenal glands. Evidence: TAS. Frequency: Frequent (HP:0040282). (ORPHA:289548)
- Premature birth (HP:0001622): The birth of a baby of less than 37 weeks of gestational age. Evidence: TAS. Frequency: Frequent (HP:0040282). (ORPHA:289548)
- Elevated circulating follicle stimulating hormone level (HP:0008232): An elevated concentration of follicle-stimulating hormone in the blood. Evidence: TAS. Frequency: Frequent (HP:0040282). (ORPHA:289548)
- Elevated circulating luteinizing hormone level (HP:0011969): An elevated concentration of luteinizing hormone in the blood. Evidence: TAS. Frequency: Frequent (HP:0040282). (ORPHA:289548)
- Abnormal vagina morphology (HP:0000142): Any structural abnormality of the vagina. Evidence: TAS. Frequency: Occasional (HP:0040283). (ORPHA:289548)
- Clitoral hypertrophy (HP:0008665): Hypertrophy of the clitoris. Evidence: TAS. Frequency: Occasional (HP:0040283). (ORPHA:289548)
- Adrenal calcification (HP:0010512): Calcification within the adrenal glands. Evidence: TAS. Frequency: Occasional (HP:0040283). (ORPHA:289548)
- Midshaft hypospadias (HP:0012854): Hypospadias with location of the urethral meatus in the middle of the inferior shaft of the penis. Evidence: TAS. Frequency: Occasional (HP:0040283). (ORPHA:289548)
These phenotypes are associated with the disease Inherited isolated adrenal insufficiency due to partial CYP11A1 deficiency (ORPHA:289548).